- Striae distensae (HP:0001065, a Human Phenotype Ontology term): Thinned, erythematous, depressed bands of atrophic skin. Initially, striae appear as flattened and thinned, pinkish linear regions of the skin. Striae tend to enlarge in length and become reddish or purplish. Later, striae tend to appear as white, depressed bands that are parallel to the lines of skin tension. Striae distensae occur most often in areas that have been subject to distension such as the lower back, buttocks, thighs, breast, abdomen, and shoulders. Evidence: IEA. (OMIM:178995)
- Autosomal dominant inheritance (HP:0000006, a Human Phenotype Ontology term): A mode of inheritance that is observed for traits related to a gene encoded on one of the autosomes (i.e., the human chromosomes 1-22) in which a trait manifests in heterozygotes. In the context of medical genetics, an autosomal dominant disorder is caused when a single copy of the mutant allele is present. Males and females are affected equally, and can both transmit the disorder with a risk of 50% for each child of inheriting the mutant allele. Evidence: IEA. (OMIM:178995)
These phenotypes are associated with the disease pruritic urticarial papules and plaques of pregnancy (OMIM:178995, an entry in Online Mendelian Inheritance in Man).